Phenotypes associated with the disease fibular aplasia-ectrodactyly syndrome (OMIM:113310):
- Brachydactyly (HP:0001156): Digits that appear disproportionately short compared to the hand/foot. The word brachydactyly is used here to describe a series distinct patterns of shortened digits (brachydactyly types A-E). This is the sense used here. Evidence: IEA. (OMIM:113310)
- Aplasia/Hypoplasia of the fibula (HP:0006492): Absence or underdevelopment of the fibula. Evidence: IEA. (OMIM:113310)
- Fibular aplasia (HP:0002990): Absence of the fibula. Evidence: TAS. (OMIM:113310)
- Variable expressivity (HP:0003828): A variable severity of phenotypic features. Evidence: TAS. (OMIM:113310)
- Split foot (HP:0001839): A condition in which middle parts of the foot (toes and metatarsals) are missing giving a cleft appearance. The severity is very variable ranging from slightly hypoplastic 3rd toe over absent 2nd or 3rd toes as far as oligo- or monodactyl feet. Evidence: TAS. (OMIM:113310)
- Typified by incomplete penetrance (HP:0003829): Description of conditions in which not all individuals with a given genotype exhibit the disease. Penetrance is the proportion that develop disease given a lifespan of 80 years. Evidence: TAS. (OMIM:113310)
- Short phalanx of finger (HP:0009803): Short (hypoplastic) phalanx of finger, affecting one or more phalanges. Evidence: IEA. (OMIM:113310)
- Autosomal dominant inheritance (HP:0000006): A mode of inheritance that is observed for traits related to a gene encoded on one of the autosomes (i.e., the human chromosomes 1-22) in which a trait manifests in heterozygotes. In the context of medical genetics, an autosomal dominant disorder is caused when a single copy of the mutant allele is present. Males and females are affected equally, and can both transmit the disorder with a risk of 50% for each child of inheriting the mutant allele. Evidence: TAS. (OMIM:113310)